Phenotypes associated with the disease lysine malabsorption syndrome (OMIM:247950):
- Renal tubular lysine transport defect (HP:0008272). Evidence: IEA. (OMIM:247950)
- Hyperlysinuria (HP:0003297): An increased concentration of lysine in the urine. Evidence: IEA. (OMIM:247950)
- Autosomal recessive inheritance (HP:0000007): A mode of inheritance that is observed for traits related to a gene encoded on one of the autosomes (i.e., the human chromosomes 1-22) in which a trait manifests in individuals with two pathogenic alleles, either homozygotes (two copies of the same mutant allele) or compound heterozygotes (whereby each copy of a gene has a distinct mutant allele). Evidence: IEA. (OMIM:247950)
- Growth delay (HP:0001510): A deficiency or slowing down of growth pre- and postnatally. Evidence: IEA. (OMIM:247950)
- Intellectual disability (HP:0001249): The term intellectual disability or intellectual developmental disorder is used to describe significantly sub-average intellectual and adaptive functioning based on clinical assessment and as measured by individually administered, appropriately normed, standardized and validated tests of intellectual functioning and adaptive behavior, with onset during the developmental period from infancy through adolescence. Evidence: IEA. (OMIM:247950)